- Congenital onset (HP:0003577): A phenotypic abnormality that is present at birth. Evidence: PCS. Frequency: 3/3. (PMID:23122586)
- Sensorineural hearing impairment (HP:0000407): A type of hearing impairment in one or both ears related to an abnormal functionality of the cochlear nerve. Evidence: PCS. Frequency: 7/7. (PMID:23122586)
- Vestibular hyporeflexia (HP:0001756): A general descriptive term that describes impaired functioning of the vestibular apparatus that leads to manifestations such as dizziness or postural imbalance. Evidence: PCS. Frequency: 1/7. (PMID:23122586)
- Autosomal recessive inheritance (HP:0000007): A mode of inheritance that is observed for traits related to a gene encoded on one of the autosomes (i.e., the human chromosomes 1-22) in which a trait manifests in individuals with two pathogenic alleles, either homozygotes (two copies of the same mutant allele) or compound heterozygotes (whereby each copy of a gene has a distinct mutant allele). Evidence: PCS. (PMID:23122586)
These phenotypes are associated with the disease autosomal recessive nonsyndromic hearing loss 84B (OMIM:614944).